- Autosomal dominant inheritance (HP:0000006): A mode of inheritance that is observed for traits related to a gene encoded on one of the autosomes (i.e., the human chromosomes 1-22) in which a trait manifests in heterozygotes. In the context of medical genetics, an autosomal dominant disorder is caused when a single copy of the mutant allele is present. Males and females are affected equally, and can both transmit the disorder with a risk of 50% for each child of inheriting the mutant allele. Evidence: IEA. (OMIM:126850)
- Duodenal ulcer (HP:0002588): An erosion of the mucous membrane in a portion of the duodenum. Evidence: IEA. (OMIM:126850)
- Hyperpepsinogenemia I (HP:0003238): The concentration of pepsinogen I in the blood circulation is above the upper limit of normal. Evidence: IEA. (OMIM:126850)
These phenotypes are associated with the disease duodenal ulcer, hyperpepsinogenemic 1 (OMIM:126850).